- Secundum atrial septal defect (HP:0001684): A kind of atrial septum defect arising from an enlarged foramen ovale, inadequate growth of the septum secundum, or excessive absorption of the septum primum. Evidence: PCS. Frequency: 20/20. Onset: Congenital onset (HP:0003577). (PMID:17947298)
- Autosomal dominant inheritance (HP:0000006): A mode of inheritance that is observed for traits related to a gene encoded on one of the autosomes (i.e., the human chromosomes 1-22) in which a trait manifests in heterozygotes. In the context of medical genetics, an autosomal dominant disorder is caused when a single copy of the mutant allele is present. Males and females are affected equally, and can both transmit the disorder with a risk of 50% for each child of inheriting the mutant allele. Evidence: PCS. (PMID:17947298)
These phenotypes are associated with the disease atrial septal defect 5 (OMIM:612794).